Phenotypes associated with the disease platelet-type bleeding disorder 20 (OMIM:616913):
- Menorrhagia (HP:0000132): Prolonged and excessive menses at regular intervals in excess of 80 mL or lasting longer than 7 days. Evidence: PCS. (PMID:26280575)
- Bruising susceptibility (HP:0000978): An ecchymosis (bruise) refers to the skin discoloration caused by the escape of blood into the tissues from ruptured blood vessels. This term refers to an abnormally increased susceptibility to bruising. The corresponding phenotypic abnormality is generally elicited on medical history as a report of frequent ecchymoses or bruising without adequate trauma. Evidence: PCS. (PMID:26280575)
- Epistaxis (HP:0000421): Epistaxis, or nosebleed, refers to a hemorrhage localized in the nose. Evidence: PCS. (PMID:26280575)
- Thrombocytopenia (HP:0001873): A reduction in the number of circulating thrombocytes. Evidence: PCS. Frequency: 8/8. (PMID:26280575)
- Autosomal dominant inheritance (HP:0000006): A mode of inheritance that is observed for traits related to a gene encoded on one of the autosomes (i.e., the human chromosomes 1-22) in which a trait manifests in heterozygotes. In the context of medical genetics, an autosomal dominant disorder is caused when a single copy of the mutant allele is present. Males and females are affected equally, and can both transmit the disorder with a risk of 50% for each child of inheriting the mutant allele. Evidence: PCS. (PMID:26280575)